Phenotypes associated with the disease intellectual disability, X-linked 107 (OMIM:301013):
- Narrow face (HP:0000275): Bizygomatic (upper face) and bigonial (lower face) width are both more than 2 standard deviations below the mean (objective); or, an apparent reduction in the width of the upper and lower face (subjective). Evidence: PCS. Frequency: 2/6. (PMID:29374277)
- Upslanted palpebral fissure (HP:0000582): The palpebral fissure inclination is more than two standard deviations above the mean for age (objective); or, the inclination of the palpebral fissure is greater than typical for age. Evidence: PCS. Frequency: 3/6. (PMID:29374277)
- Long face (HP:0000276): Facial height (length) is more than 2 standard deviations above the mean (objective); or, an apparent increase in the height (length) of the face (subjective). Evidence: PCS. Frequency: 5/6. (PMID:29374277)
- Seizure (HP:0001250): A seizure is an intermittent abnormality of nervous system physiology characterized by a transient occurrence of signs and/or symptoms due to abnormal excessive or synchronous neuronal activity in the brain. Evidence: PCS. Frequency: 1/6. (PMID:29374277)
- Global developmental delay (HP:0001263): A delay in the achievement of motor or mental milestones in the domains of development of a child, including motor skills, speech and language, cognitive skills, and social and emotional skills. This term should only be used to describe children younger than five years of age. Evidence: PCS. Frequency: 6/6. (PMID:29374277)
- Broad chin (HP:0011822): Increased width of the midpoint of the mandible (mental protuberance) and overlying soft tissue. Evidence: PCS. Frequency: 1/6. (PMID:29374277)
- Abnormality of superior crus of antihelix (HP:0011245): An abnormality of the superior crus of the antihelix is the upper cartilaginous ridge arising at the bifurcation of the antihelix that ends beneath the fold of the ascending helix, and separates the concha from the triangular fossa. Evidence: PCS. Frequency: 1/6. (PMID:29374277)
- Smooth philtrum (HP:0000319): Flat skin surface, with no ridge formation in the central region of the upper lip between the nasal base and upper vermilion border. Evidence: PCS. Frequency: 2/6. (PMID:29374277)
- Aggressive behavior (HP:0000718): Behavior or an act aimed at harming a person, animal, or physical property (e.g., acts of physical violence; shouting, swearing, and using harsh language; slashing someone's tires). Evidence: PCS. Frequency: 1/6. (PMID:29374277)
- Autistic behavior (HP:0000729): Persistent deficits in social interaction and communication and interaction as well as a markedly restricted repertoire of activity and interest as well as repetitive patterns of behavior. Evidence: PCS. Frequency: 2/6. (PMID:29374277)
- Anxiety (HP:0000739): Intense feelings of nervousness, tension, or panic often arise in response to interpersonal stresses. There is worry about the negative effects of past unpleasant experiences and future negative possibilities. Individuals may feel fearful, apprehensive, or threatened by uncertainty, and they may also have fears of falling apart or losing control. Evidence: PCS. Frequency: 1/6. (PMID:29374277)
- Broad forehead (HP:0000337): Width of the forehead or distance between the frontotemporales is more than two standard deviations above the mean (objective); or apparently increased distance between the two sides of the forehead. Evidence: PCS. Frequency: 2/6. (PMID:29374277)
- Thin upper lip vermilion (HP:0000219): Height of the vermilion of the upper lip in the midline more than 2 SD below the mean. Alternatively, an apparently reduced height of the vermilion of the upper lip in the frontal view (subjective). Evidence: PCS. Frequency: 1/6. (PMID:29374277)
- X-linked inheritance (HP:0001417): A mode of inheritance that is observed for traits related to a gene encoded on the X chromosome. Evidence: PCS. (PMID:29374277)
- Hyperactivity (HP:0000752): Hyperactivity is a condition characterized by constant and unusually high levels of activity, even in situations where it is deemed inappropriate. Evidence: PCS. Frequency: 1/6. (PMID:29374277)
- Macrotia (HP:0000400): Median longitudinal ear length greater than two standard deviations above the mean and median ear width greater than two standard deviations above the mean (objective); or, apparent increase in length and width of the pinna (subjective). Evidence: PCS. Frequency: 3/6. (PMID:29374277)
- Attention deficit hyperactivity disorder (HP:0007018): Attention deficit hyperactivity disorder (ADHD) manifests at age 2-3 years or by first grade at the latest. The main symptoms are distractibility, impulsivity, hyperactivity, and often trouble organizing tasks and projects, difficulty going to sleep, and social problems from being aggressive, loud, or impatient. Evidence: PCS. Frequency: 1/6. (PMID:29374277)
- Prominent crus of helix (HP:0009899): The presence of an abnormally prominent of the crus of the helix. That is, development of the crus helix to the same degree as an average antihelix stem or helix. Evidence: PCS. Frequency: 2/6. (PMID:29374277)
- Intellectual disability (HP:0001249): The term intellectual disability or intellectual developmental disorder is used to describe significantly sub-average intellectual and adaptive functioning based on clinical assessment and as measured by individually administered, appropriately normed, standardized and validated tests of intellectual functioning and adaptive behavior, with onset during the developmental period from infancy through adolescence. Evidence: PCS. Frequency: 6/6. (PMID:29374277)
- Mandibular prognathia (HP:0000303): Abnormal prominence of the chin related to increased length of the mandible. Evidence: PCS. Frequency: 3/6. (PMID:29374277)
- Obesity (HP:0001513): Accumulation of substantial excess body fat. Evidence: PCS. Frequency: 1/6. (PMID:29374277)